Phenotypes associated with the disease Stickler syndrome (ORPHA:828):
- Malar flattening (HP:0000272): Underdevelopment of the malar prominence of the jugal bone (zygomatic bone in mammals), appreciated in profile, frontal view, and/or by palpation. Evidence: TAS. Frequency: Very frequent (HP:0040281). (ORPHA:828)
- Epicanthus (HP:0000286): A fold of skin starting above the medial aspect of the upper eyelid and arching downward to cover, pass in front of and lateral to the medial canthus. Evidence: TAS. Frequency: Very frequent (HP:0040281). (ORPHA:828)
- Microretrognathia (HP:0000308): A form of developmental hypoplasia of the mandible in which the mandible is mislocalised posteriorly. Evidence: TAS. Frequency: Very frequent (HP:0040281). (ORPHA:828)
- Hypoplasia of the maxilla (HP:0000327): Abnormally small dimension of the Maxilla. Usually creating a malocclusion or malalignment between the upper and lower teeth or resulting in a deficient amount of projection of the base of the nose and lower midface region. Evidence: TAS. Frequency: Very frequent (HP:0040281). (ORPHA:828)
- Long philtrum (HP:0000343): Distance between nasal base and midline upper lip vermilion border more than 2 SD above the mean. Alternatively, an apparently increased distance between nasal base and midline upper lip vermilion border. Evidence: TAS. Frequency: Very frequent (HP:0040281). (ORPHA:828)
- Visual impairment (HP:0000505): Visual impairment (or vision impairment) is vision loss (of a person) to such a degree as to qualify as an additional support need through a significant limitation of visual capability resulting from either disease, trauma, or congenital or degenerative conditions that cannot be corrected by conventional means, such as refractive correction, medication, or surgery. Evidence: TAS. Frequency: Very frequent (HP:0040281). (ORPHA:828)
- Telecanthus (HP:0000506): Distance between the inner canthi more than two standard deviations above the mean (objective); or, apparently increased distance between the inner canthi. Evidence: TAS. Frequency: Very frequent (HP:0040281). (ORPHA:828)
- Cataract (HP:0000518): A cataract is an opacity or clouding that develops in the crystalline lens of the eye or in its capsule. Evidence: TAS. Frequency: Very frequent (HP:0040281). (ORPHA:828)
- Retinal detachment (HP:0000541): Separation of the inner layers of the retina (neural retina) from the pigment epithelium. Evidence: TAS. Frequency: Very frequent (HP:0040281). (ORPHA:828)
- Myopia (HP:0000545): An abnormality of refraction characterized by the ability to see objects nearby clearly, while objects in the distance appear blurry. Evidence: TAS. Frequency: Very frequent (HP:0040281). (ORPHA:828)
- Skeletal dysplasia (HP:0002652): A general term describing features characterized by abnormal development of bones and connective tissues. Evidence: TAS. Frequency: Very frequent (HP:0040281). (ORPHA:828)
- Arthralgia (HP:0002829): Joint pain. Evidence: TAS. Frequency: Very frequent (HP:0040281). (ORPHA:828)
- Short nose (HP:0003196): Distance from nasion to subnasale more than two standard deviations below the mean, or alternatively, an apparently decreased length from the nasal root to the nasal tip. Evidence: TAS. Frequency: Very frequent (HP:0040281). (ORPHA:828)
- Abnormal vertebral body morphology (HP:0003312): Abnormal form of vertebral body, which is the central cylindrical portion of the vertebra that together with other structures such as the vertebral arch, pedicles, laminae, spinous process, transverse processes, and articular facets makes up a vertebra. Evidence: TAS. Frequency: Very frequent (HP:0040281). (ORPHA:828)
- Abnormal vitreous humor morphology (HP:0004327): Any structural anomaly of the vitreous body. Evidence: TAS. Frequency: Very frequent (HP:0040281). (ORPHA:828)
- Depressed nasal bridge (HP:0005280): Posterior positioning of the nasal root in relation to the overall facial profile for age. Evidence: TAS. Frequency: Very frequent (HP:0040281). (ORPHA:828)
- Abnormal epiphysis morphology (HP:0005930): An anomaly of epiphysis, which is the expanded articular end of a long bone that developes from a secondary ossification center, and which during the period of growth is either entirely cartilaginous or is separated from the shaft by a cartilaginous disk. Evidence: TAS. Frequency: Very frequent (HP:0040281). (ORPHA:828)
- Midface retrusion (HP:0011800): Posterior positions and/or vertical shortening of the infraorbital and perialar regions, or increased concavity of the face and/or reduced nasolabial angle. Evidence: TAS. Frequency: Very frequent (HP:0040281). (ORPHA:828)
- Macroglossia (HP:0000158): Increased length and width of the tongue. Evidence: TAS. Frequency: Frequent (HP:0040282). (ORPHA:828)
- Glossoptosis (HP:0000162): Posterior displacement of the tongue into the pharynx, i.e., a tongue that is mislocalised posteriorly. Evidence: TAS. Frequency: Frequent (HP:0040282). (ORPHA:828)
- Cleft palate (HP:0000175): Cleft palate is a developmental defect of the palate resulting from a failure of fusion of the palatine processes and manifesting as a separation of the roof of the mouth (soft and hard palate). Evidence: TAS. Frequency: Frequent (HP:0040282). (ORPHA:828)
- Bifid uvula (HP:0000193): Uvula separated into two parts most easily seen at the tip. Evidence: TAS. Frequency: Frequent (HP:0040282). (ORPHA:828)
- Cleft upper lip (HP:0000204): A gap or groove in the upper lip. This is a congenital defect resulting from nonfusion of tissues of the lip during embryonal development. Evidence: TAS. Frequency: Frequent (HP:0040282). (ORPHA:828)
- Micrognathia (HP:0000347): Developmental hypoplasia of the mandible. Evidence: TAS. Frequency: Frequent (HP:0040282). (ORPHA:828)
- Hearing impairment (HP:0000365): A decreased magnitude of the sensory perception of sound. Evidence: TAS. Frequency: Frequent (HP:0040282). (ORPHA:828)
- Chronic otitis media (HP:0000389): Chronic otitis media refers to fluid, swelling, or infection of the middle ear that does not heal and may cause permanent damage to the ear. Evidence: TAS. Frequency: Frequent (HP:0040282). (ORPHA:828)
- Sensorineural hearing impairment (HP:0000407): A type of hearing impairment in one or both ears related to an abnormal functionality of the cochlear nerve. Evidence: TAS. Frequency: Frequent (HP:0040282). (ORPHA:828)
- Depressed nasal ridge (HP:0000457): Lack of prominence of the nose resulting from a posteriorly-placed nasal ridge. Evidence: TAS. Frequency: Frequent (HP:0040282). (ORPHA:828)
- Anteverted nares (HP:0000463): Anteriorly-facing nostrils viewed with the head in the Frankfurt horizontal and the eyes of the observer level with the eyes of the subject. This gives the appearance of an upturned nose (upturned nasal tip). Evidence: TAS. Frequency: Frequent (HP:0040282). (ORPHA:828)
- Astigmatism (HP:0000483): A type of refraction error associated with abnormal curvatures on the anterior and/or posterior surface of the cornea. Evidence: TAS. Frequency: Frequent (HP:0040282). (ORPHA:828)
- Proptosis (HP:0000520): An eye that is protruding anterior to the plane of the face to a greater extent than is typical. Evidence: TAS. Frequency: Frequent (HP:0040282). (ORPHA:828)
- Pectus carinatum (HP:0000768): A deformity of the chest caused by overgrowth of the ribs and characterized by protrusion of the sternum. Evidence: TAS. Frequency: Frequent (HP:0040282). (ORPHA:828)
- Platyspondyly (HP:0000926): A flattened vertebral body shape with reduced distance between the vertebral endplates. Evidence: TAS. Frequency: Frequent (HP:0040282). (ORPHA:828)
- Arachnodactyly (HP:0001166): Abnormally long and slender fingers (spider fingers). Evidence: TAS. Frequency: Frequent (HP:0040282). (ORPHA:828)
- Hypotonia (HP:0001252): Hypotonia is an abnormally low muscle tone (the amount of tension or resistance to movement in a muscle). Even when relaxed, muscles have a continuous and passive partial contraction which provides some resistance to passive stretching. Hypotonia thus manifests as diminished resistance to passive stretching. Hypotonia is not the same as muscle weakness, although the two conditions can co-exist. Evidence: TAS. Frequency: Frequent (HP:0040282). (ORPHA:828)
- Joint dislocation (HP:0001373): Displacement or malalignment of joints. Evidence: TAS. Frequency: Frequent (HP:0040282). (ORPHA:828)
- Disproportionate tall stature (HP:0001519): A tall and slim body build with increased arm span to height ratio (>1.05) and a reduced upper-to-lower segment ratio (<0.85), i.e., unusually long arms and legs. The extremities as well as the hands and feet are unusually slim. Evidence: TAS. Frequency: Frequent (HP:0040282). (ORPHA:828)
- Mitral valve prolapse (HP:0001634): One or both of the leaflets (cusps) of the mitral valve bulges back into the left atrium upon contraction of the left ventricle. Evidence: TAS. Frequency: Frequent (HP:0040282). (ORPHA:828)
- Gastroesophageal reflux (HP:0002020): A condition in which the stomach contents leak backwards from the stomach into the esophagus through the lower esophageal sphincter. Evidence: TAS. Frequency: Frequent (HP:0040282). (ORPHA:828)
- Recurrent respiratory infections (HP:0002205): An increased susceptibility to respiratory infections as manifested by a history of recurrent respiratory infections. Evidence: TAS. Frequency: Frequent (HP:0040282). (ORPHA:828)
- Scoliosis (HP:0002650): The presence of an abnormal lateral curvature of the spine. Evidence: TAS. Frequency: Frequent (HP:0040282). (ORPHA:828)
- Bone pain (HP:0002653): An unpleasant sensation characterized by physical discomfort (such as pricking, throbbing, or aching) localized to bone. Evidence: TAS. Frequency: Frequent (HP:0040282). (ORPHA:828)
- Osteoarthritis (HP:0002758): Degeneration (wear and tear) of articular cartilage, i.e., of the joint surface. Joint degeneration may be accompanied by osteophytes (bone overgrowth), narrowing of the joint space, regions of sclerosis at the joint surface, or joint deformity. Evidence: TAS. Frequency: Frequent (HP:0040282). (ORPHA:828)
- Kyphosis (HP:0002808): Exaggerated anterior convexity of the thoracic vertebral column. Evidence: TAS. Frequency: Frequent (HP:0040282). (ORPHA:828)
- Genu valgum (HP:0002857): The legs angle inward, such that the knees are close together and the ankles far apart. Evidence: TAS. Frequency: Frequent (HP:0040282). (ORPHA:828)
- Spondylolisthesis (HP:0003302): Complete bilateral fractures of the pars interarticularis resulting in the anterior slippage of the vertebra. Evidence: TAS. Frequency: Frequent (HP:0040282). (ORPHA:828)
- Proximal femoral epiphysiolysis (HP:0006461): Slipped capital femoral epiphysis is defined as a posterior and inferior slippage of the proximal epiphysis of the femur onto the metaphysis (femoral neck), occurring through the physeal plate during the early adolescent growth spurt. Evidence: TAS. Frequency: Frequent (HP:0040282). (ORPHA:828)
- Lattice retinal degeneration (HP:0007992): A pattern of white lines and dots in the far periphery of the retina. Evidence: TAS. Frequency: Frequent (HP:0040282). (ORPHA:828)
- High myopia (HP:0011003): A severe form of myopia with greater than -6.00 diopters. Evidence: TAS. Frequency: Frequent (HP:0040282). (ORPHA:828)
- Retinal hole (HP:0011530): A full-thickness defect in the retina. Evidence: TAS. Frequency: Frequent (HP:0040282). (ORPHA:828)
- Arrhythmia (HP:0011675): Any cardiac rhythm other than the normal sinus rhythm. Such a rhythm may be either of sinus or ectopic origin and either regular or irregular. An arrhythmia may be due to a disturbance in impulse formation or conduction or both. Evidence: TAS. Frequency: Frequent (HP:0040282). (ORPHA:828)
- Membranous vitreous appearance (HP:0031153): Vitreous humor of the eye displaying consisting of a vestigial gel in the retrolental space bounded by a convoluted membrane. Evidence: TAS. Frequency: Frequent (HP:0040282). (ORPHA:828)
- Hypertelorism (HP:0000316): Interpupillary distance more than 2 SD above the mean (alternatively, the appearance of an increased interpupillary distance or widely spaced eyes). Evidence: TAS. Frequency: Occasional (HP:0040283). (ORPHA:828)
- Strabismus (HP:0000486): A misalignment of the eyes so that the visual axes deviate from bifoveal fixation. The classification of strabismus may be based on a number of features including the relative position of the eyes, whether the deviation is latent or manifest, intermittent or constant, concomitant or otherwise and according to the age of onset and the relevance of any associated refractive error. Evidence: TAS. Frequency: Occasional (HP:0040283). (ORPHA:828)
- Glaucoma (HP:0000501): Glaucoma refers loss of retinal ganglion cells in a characteristic pattern of optic neuropathy usually associated with increased intraocular pressure. Evidence: TAS. Frequency: Occasional (HP:0040283). (ORPHA:828)
- Developmental cataract (HP:0000519): A cataract that occurs congenitally as the result of a developmental defect, in contrast to the majority of cataracts that occur in adulthood as the result of degenerative changes of the lens. Evidence: TAS. Frequency: Occasional (HP:0040283). (ORPHA:828)
- Uveitis (HP:0000554): Inflammation of one or all portions of the uveal tract. Evidence: TAS. Frequency: Occasional (HP:0040283). (ORPHA:828)
- Blindness (HP:0000618): Blindness is the condition of lacking visual perception defined as a profound reduction in visual perception. On the 6m visual acuity scale, blindness is defined as less than 3/60. On the 20ft visual acuity scale, blindness is defined as less than 20/400. On the decimal visual acuity scale, blindness is defined as less than 0.05. Blindness is typically characterized by a visual field of no greater than 10 degrees in radius around central fixation. Evidence: TAS. Frequency: Occasional (HP:0040283). (ORPHA:828)
- Abnormal dental enamel morphology (HP:0000682): An abnormality of the dental enamel. Evidence: TAS. Frequency: Occasional (HP:0040283). (ORPHA:828)
- Abnormal diaphysis morphology (HP:0000940): An abnormality of the structure or form of the diaphysis, i.e., of the main or mid-section (shaft) of a long bone. Evidence: TAS. Frequency: Occasional (HP:0040283). (ORPHA:828)
- Ectopia lentis (HP:0001083): Dislocation or malposition of the crystalline lens of the eye. A partial displacement (or dislocation) of the lens is described as a subluxation of the lens, while a complete displacement is termed luxation of the lens. A complete displacement occurs if the lens is completely outside the patellar fossa of the lens, either in the anterior chamber, in the vitreous, or directly on the retina. If the lens is partially displaced but still contained within the lens space, then it is termed subluxation. Evidence: TAS. Frequency: Occasional (HP:0040283). (ORPHA:828)
- Slender build (HP:0001533): Asthenic habitus refers to a slender build with long limbs, an angular profile, and prominent muscles or bones. Evidence: TAS. Frequency: Occasional (HP:0040283). (ORPHA:828)
- Hip dislocation (HP:0002827): Displacement of the femur from its normal location in the hip joint. Evidence: TAS. Frequency: Occasional (HP:0040283). (ORPHA:828)
- Protrusio acetabuli (HP:0003179): Intrapelvic bulging of the medial acetabular wall. Evidence: TAS. Frequency: Occasional (HP:0040283). (ORPHA:828)
- Skeletal muscle atrophy (HP:0003202): The presence of skeletal muscular atrophy (which is also known as amyotrophy). Evidence: TAS. Frequency: Occasional (HP:0040283). (ORPHA:828)
- Spinal canal stenosis (HP:0003416): An abnormal narrowing of the spinal canal. Evidence: TAS. Frequency: Occasional (HP:0040283). (ORPHA:828)
- Short stature (HP:0004322): A height below that which is expected according to age and gender norms. Although there is no universally accepted definition of short stature, many refer to "short stature" as height more than 2 standard deviations below the mean for age and gender (or below the 3rd percentile for age and gender dependent norms). Evidence: TAS. Frequency: Occasional (HP:0040283). (ORPHA:828)
- Cachexia (HP:0004326): Severe weight loss, wasting of muscle, loss of appetite, and general debility related to a chronic disease. Evidence: TAS. Frequency: Occasional (HP:0040283). (ORPHA:828)
- Reduced bone mineral density (HP:0004349): A reduction of bone mineral density, that is, of the amount of matter per cubic centimeter of bones. Evidence: TAS. Frequency: Occasional (HP:0040283). (ORPHA:828)
- Hemiplegia/hemiparesis (HP:0004374): Loss of strength in the arm, leg, and sometimes face on one side of the body. Hemiplegia refers to a severe or complete loss of strength, whereas hemiparesis refers to a relatively mild loss of strength. Evidence: TAS. Frequency: Occasional (HP:0040283). (ORPHA:828)
- Advanced eruption of teeth (HP:0006288): Premature tooth eruption, which can be defined as tooth eruption more than 2 SD earlier than the mean eruption age. Evidence: TAS. Frequency: Occasional (HP:0040283). (ORPHA:828)
- Feeding difficulties in infancy (HP:0008872): Impaired feeding performance of an infant as manifested by difficulties such as weak and ineffective sucking, brief bursts of sucking, and falling asleep during sucking. There may be difficulties with chewing or maintaining attention. Evidence: TAS. Frequency: Occasional (HP:0040283). (ORPHA:828)
- Tooth agenesis (HP:0009804): The absence of one or more teeth from the normal series by a failure to develop. Evidence: TAS. Frequency: Occasional (HP:0040283). (ORPHA:828)
- Short hard palate (HP:0010290): Distance between the labial point of the incisive papilla to the midline junction of the hard and soft palate more than 2 SD below the mean (objective) or apparently decreased length of the hard palate (subjective). Evidence: TAS. Frequency: Occasional (HP:0040283). (ORPHA:828)
- Open bite (HP:0010807): Visible space between the dental arches in occlusion. Evidence: TAS. Frequency: Occasional (HP:0040283). (ORPHA:828)
- Beaded vitreous appearance (HP:0031154): Vitreous humor of the eye displaying beaded bundles of irregular diameters. Evidence: TAS. Frequency: Occasional (HP:0040283). (ORPHA:828)
- Joint hypermobility (HP:0001382): The capability that a joint (or a group of joints) has to move, passively and/or actively, beyond normal limits along physiological axes. Evidence: TAS. Frequency: Frequent (HP:0040282). (ORPHA:828)